Phenotypes associated with the disease NYSTAGMUS, VOLUNTARY (OMIM:164170):
- Nystagmus (HP:0000639): Rhythmic, involuntary oscillations of one or both eyes related to abnormality in fixation, conjugate gaze, or vestibular mechanisms. Evidence: TAS. (OMIM:164170)
- Autosomal dominant inheritance (HP:0000006): A mode of inheritance that is observed for traits related to a gene encoded on one of the autosomes (i.e., the human chromosomes 1-22) in which a trait manifests in heterozygotes. In the context of medical genetics, an autosomal dominant disorder is caused when a single copy of the mutant allele is present. Males and females are affected equally, and can both transmit the disorder with a risk of 50% for each child of inheriting the mutant allele. Evidence: IEA. (OMIM:164170)